Phenotypes associated with the disease Cataract-ataxia-deafness syndrome (ORPHA:1368):
- Sensorineural hearing impairment (HP:0000407): A type of hearing impairment in one or both ears related to an abnormal functionality of the cochlear nerve. Evidence: TAS. Frequency: Very frequent (HP:0040281). (ORPHA:1368)
- Visual impairment (HP:0000505): Visual impairment (or vision impairment) is vision loss (of a person) to such a degree as to qualify as an additional support need through a significant limitation of visual capability resulting from either disease, trauma, or congenital or degenerative conditions that cannot be corrected by conventional means, such as refractive correction, medication, or surgery. Evidence: TAS. Frequency: Frequent (HP:0040282). (ORPHA:1368)
- Developmental cataract (HP:0000519): A cataract that occurs congenitally as the result of a developmental defect, in contrast to the majority of cataracts that occur in adulthood as the result of degenerative changes of the lens. Evidence: TAS. Frequency: Very frequent (HP:0040281). (ORPHA:1368)
- Nystagmus (HP:0000639): Rhythmic, involuntary oscillations of one or both eyes related to abnormality in fixation, conjugate gaze, or vestibular mechanisms. Evidence: TAS. Frequency: Frequent (HP:0040282). (ORPHA:1368)
- Decreased nerve conduction velocity (HP:0000762): A reduction in the speed at which electrical signals propagate along the axon of a neuron. Evidence: TAS. Frequency: Very frequent (HP:0040281). (ORPHA:1368)
- Ataxia (HP:0001251): Ataxia refers to impaired coordination of voluntary muscle movement. Cerebellar ataxia refers to ataxia due to dysfunction of the cerebellum. This causes a variety of elementary neurological deficits including asynergy (lack of coordination between muscles, limbs and joints), dysmetria (lack of ability to judge distances that can lead to under- or overshoot in grasping movements), and dysdiadochokinesia (inability to perform rapid movements requiring antagonizing muscle groups to be switched on and off repeatedly). Evidence: TAS. Frequency: Very frequent (HP:0040281). (ORPHA:1368)
- Mild intellectual disability (HP:0001256): Mild intellectual disability (ID) is defined as a type of ID characterized by mildly sub-average adaptive functioning and intellectual functioning, with an intelligence quotient (IQ) the range of 50-69. Evidence: TAS. Frequency: Very frequent (HP:0040281). (ORPHA:1368)
- Hypertonia (HP:0001276): A condition in which there is increased muscle tone so that arms or legs, for example, are stiff and difficult to move. Evidence: TAS. Frequency: Very frequent (HP:0040281). (ORPHA:1368)
- Areflexia (HP:0001284): Absence of neurologic reflexes such as the knee-jerk reaction. Evidence: TAS. Frequency: Very frequent (HP:0040281). (ORPHA:1368)
- Tremor (HP:0001337): An unintentional, oscillating to-and-fro muscle movement about a joint axis. Evidence: TAS. Frequency: Frequent (HP:0040282). (ORPHA:1368)
- Short stature (HP:0004322): A height below that which is expected according to age and gender norms. Although there is no universally accepted definition of short stature, many refer to "short stature" as height more than 2 standard deviations below the mean for age and gender (or below the 3rd percentile for age and gender dependent norms). Evidence: TAS. Frequency: Frequent (HP:0040282). (ORPHA:1368)
- Adult onset sensorineural hearing impairment (HP:0008615): The presence of sensorineural deafness with late onset. Evidence: TAS. Frequency: Very frequent (HP:0040281). (ORPHA:1368)
- Peripheral neuropathy (HP:0009830): Peripheral neuropathy is a general term for any disorder of the peripheral nervous system. The main clinical features used to classify peripheral neuropathy are distribution, type (mainly demyelinating versus mainly axonal), duration, and course. Evidence: TAS. Frequency: Very frequent (HP:0040281). (ORPHA:1368)